- Menorrhagia (HP:0000132): Prolonged and excessive menses at regular intervals in excess of 80 mL or lasting longer than 7 days. Evidence: TAS. (OMIM:601709)
- Bruising susceptibility (HP:0000978): An ecchymosis (bruise) refers to the skin discoloration caused by the escape of blood into the tissues from ruptured blood vessels. This term refers to an abnormally increased susceptibility to bruising. The corresponding phenotypic abnormality is generally elicited on medical history as a report of frequent ecchymoses or bruising without adequate trauma. Evidence: IEA. (OMIM:601709)
- Joint hemorrhage (HP:0005261): Hemorrhage occurring within a joint. Evidence: TAS. (OMIM:601709)
- Impaired epinephrine-induced platelet aggregation (HP:0008148): Abnormal response to epinephrine as manifested by reduced or lacking aggregation of platelets upon addition of epinephrine. Evidence: IEA. (OMIM:601709)
- Epistaxis (HP:0000421): Epistaxis, or nosebleed, refers to a hemorrhage localized in the nose. Evidence: TAS. (OMIM:601709)
- Thrombocytopenia (HP:0001873): A reduction in the number of circulating thrombocytes. Evidence: IEA. (OMIM:601709)
- Autosomal dominant inheritance (HP:0000006): A mode of inheritance that is observed for traits related to a gene encoded on one of the autosomes (i.e., the human chromosomes 1-22) in which a trait manifests in heterozygotes. In the context of medical genetics, an autosomal dominant disorder is caused when a single copy of the mutant allele is present. Males and females are affected equally, and can both transmit the disorder with a risk of 50% for each child of inheriting the mutant allele. Evidence: PCS. (PMID:20007542)
These phenotypes are associated with the disease Quebec platelet disorder (OMIM:601709).